- Prolonged bleeding time (HP:0003010): Prolongation of the time taken for a standardized skin cut of fixed depth and length to stop bleeding. Evidence: IEA. (OMIM:177820)
- Autosomal dominant inheritance (HP:0000006): A mode of inheritance that is observed for traits related to a gene encoded on one of the autosomes (i.e., the human chromosomes 1-22) in which a trait manifests in heterozygotes. In the context of medical genetics, an autosomal dominant disorder is caused when a single copy of the mutant allele is present. Males and females are affected equally, and can both transmit the disorder with a risk of 50% for each child of inheriting the mutant allele. Evidence: IEA. (OMIM:177820)
- Intermittent thrombocytopenia (HP:0004854): Reduced platelet count that occurs sporadically, i.e., it comes and goes. Evidence: IEA. (OMIM:177820)
These phenotypes are associated with the disease platelet-type von Willebrand disease (OMIM:177820).